- Long palpebral fissure (HP:0000637): Distance between medial and lateral canthi is more than two standard deviations above the mean for age (objective); or, apparently increased length of the palpebral fissures. Evidence: TAS. Frequency: Very frequent (HP:0040281). (ORPHA:352665)
- Hypotonia (HP:0001252): Hypotonia is an abnormally low muscle tone (the amount of tension or resistance to movement in a muscle). Even when relaxed, muscles have a continuous and passive partial contraction which provides some resistance to passive stretching. Hypotonia thus manifests as diminished resistance to passive stretching. Hypotonia is not the same as muscle weakness, although the two conditions can co-exist. Evidence: TAS. Frequency: Very frequent (HP:0040281). (ORPHA:352665)
- Cryptorchidism (HP:0000028): Testis in inguinal canal. That is, absence of one or both testes from the scrotum owing to failure of the testis or testes to descend through the inguinal canal to the scrotum. Evidence: TAS. Frequency: Frequent (HP:0040282). (ORPHA:352665)
- Vesicoureteral reflux (HP:0000076): Abnormal (retrograde) movement of urine from the bladder into ureters or kidneys related to inadequacy of the valvular mechanism at the ureterovesicular junction or other causes. Evidence: TAS. Frequency: Frequent (HP:0040282). (ORPHA:352665)
- Hydronephrosis (HP:0000126): Severe distention of the kidney with dilation of the renal pelvis and calices. Evidence: TAS. Frequency: Frequent (HP:0040282). (ORPHA:352665)
- Macroglossia (HP:0000158): Increased length and width of the tongue. Evidence: TAS. Frequency: Frequent (HP:0040282). (ORPHA:352665)
- Open mouth (HP:0000194): A facial appearance characterized by a permanently or nearly permanently opened mouth. Evidence: TAS. Frequency: Frequent (HP:0040282). (ORPHA:352665)
- Microcephaly (HP:0000252): Head circumference below 2 standard deviations below the mean for age and gender. Evidence: TAS. Frequency: Frequent (HP:0040282). (ORPHA:352665)
- Long face (HP:0000276): Facial height (length) is more than 2 standard deviations above the mean (objective); or, an apparent increase in the height (length) of the face (subjective). Evidence: TAS. Frequency: Frequent (HP:0040282). (ORPHA:352665)
- Wide nasal bridge (HP:0000431): Increased breadth of the nasal bridge (and with it, the nasal root). Evidence: TAS. Frequency: Frequent (HP:0040282). (ORPHA:352665)
- Broad nasal tip (HP:0000455): Increase in width of the nasal tip. Evidence: TAS. Frequency: Frequent (HP:0040282). (ORPHA:352665)
- Dental malocclusion (HP:0000689): Dental malocclusion refers to an abnormality of the occlusion, or alignment, of the teeth and the way the upper and lower teeth fit together, resulting in overcrowding of teeth or in abnormal bite patterns. Evidence: TAS. Frequency: Frequent (HP:0040282). (ORPHA:352665)
- Craniosynostosis (HP:0001363): Craniosynostosis refers to the premature closure of the cranial sutures. Primary craniosynostosis refers to the closure of one or more sutures due to abnormalities in skull development, and secondary craniosynostosis results from failure of brain growth. Evidence: TAS. Frequency: Frequent (HP:0040282). (ORPHA:352665)
- Hip dysplasia (HP:0001385): The presence of developmental dysplasia of the hip. Evidence: TAS. Frequency: Frequent (HP:0040282). (ORPHA:352665)
- Growth delay (HP:0001510): A deficiency or slowing down of growth pre- and postnatally. Evidence: TAS. Frequency: Frequent (HP:0040282). (ORPHA:352665)
- Abnormal heart morphology (HP:0001627): Any structural anomaly of the heart. Evidence: TAS. Frequency: Frequent (HP:0040282). (ORPHA:352665)
- Ventricular septal defect (HP:0001629): A hole between the two bottom chambers (ventricles) of the heart. The defect is centered around the most superior aspect of the ventricular septum. Evidence: TAS. Frequency: Frequent (HP:0040282). (ORPHA:352665)
- Gray matter heterotopia (HP:0002282): Heterotopia or neuronal heterotopia are macroscopic clusters of misplaced neurons (gray matter), most often situated along the ventricular walls or within the subcortical white matter. Evidence: TAS. Frequency: Frequent (HP:0040282). (ORPHA:352665)
- Moderate intellectual disability (HP:0002342): Moderate intellectual disability (ID) is defined as a type of ID characterized by moderately sub-average adaptive functioning and intellectual functioning, with an intelligence quotient (IQ) the range of 35-49. Evidence: TAS. Frequency: Frequent (HP:0040282). (ORPHA:352665)
- Poor speech (HP:0002465). Evidence: TAS. Frequency: Frequent (HP:0040282). (ORPHA:352665)
- Inability to walk (HP:0002540): Incapability to ambulate. Evidence: TAS. Frequency: Frequent (HP:0040282). (ORPHA:352665)
- Scoliosis (HP:0002650): The presence of an abnormal lateral curvature of the spine. Evidence: TAS. Frequency: Frequent (HP:0040282). (ORPHA:352665)
- Exaggerated median tongue furrow (HP:0002711): Increased depth of the median tongue furrow. Evidence: TAS. Frequency: Frequent (HP:0040282). (ORPHA:352665)
- Downturned corners of mouth (HP:0002714): A morphological abnormality of the mouth in which the angle of the mouth is downturned. The oral commissures are positioned inferior to the midline labial fissure. Evidence: TAS. Frequency: Frequent (HP:0040282). (ORPHA:352665)
- Bruxism (HP:0003763): Bruxism is characterized by the grinding of the teeth including the clenching of the jaw and typically occur during sleep. Evidence: TAS. Frequency: Frequent (HP:0040282). (ORPHA:352665)
- Severe intellectual disability (HP:0010864): Severe intellectual disability (ID) is defined as a type of ID characterized by severely sub-average adaptive functioning and intellectual functioning, with an intelligence quotient (IQ) the range of 20-34. Evidence: TAS. Frequency: Frequent (HP:0040282). (ORPHA:352665)
- Increased nuchal translucency (HP:0010880): Nuchal translucency is the sonographic appearance of subcutaneous accumulation of liquid in the back of the fetal neck in the first trimester of pregnancy (11-14 gestational weeks of pregnancy). Evidence: TAS. Frequency: Frequent (HP:0040282). (ORPHA:352665)
- Delayed ability to walk (HP:0031936): A failure to achieve the ability to walk at an appropriate developmental stage. Most children learn to walk in a series of stages, and learn to walk short distances independently between 12 and 15 months. Evidence: TAS. Frequency: Frequent (HP:0040282). (ORPHA:352665)
- Cleft palate (HP:0000175): Cleft palate is a developmental defect of the palate resulting from a failure of fusion of the palatine processes and manifesting as a separation of the roof of the mouth (soft and hard palate). Evidence: TAS. Frequency: Occasional (HP:0040283). (ORPHA:352665)
- Bifid uvula (HP:0000193): Uvula separated into two parts most easily seen at the tip. Evidence: TAS. Frequency: Occasional (HP:0040283). (ORPHA:352665)
- Coarse facial features (HP:0000280): Absence of fine and sharp appearance of brows, nose, lips, mouth, and chin, usually because of rounded and heavy features or thickened skin with or without thickening of subcutaneous and bony tissues. Evidence: TAS. Frequency: Occasional (HP:0040283). (ORPHA:352665)
- Conductive hearing impairment (HP:0000405): An abnormality of vibrational conductance of sound to the inner ear leading to impairment of sensory perception of sound. Evidence: TAS. Frequency: Occasional (HP:0040283). (ORPHA:352665)
- Sensorineural hearing impairment (HP:0000407): A type of hearing impairment in one or both ears related to an abnormal functionality of the cochlear nerve. Evidence: TAS. Frequency: Occasional (HP:0040283). (ORPHA:352665)
- Protruding ear (HP:0000411): Angle formed by the plane of the ear and the mastoid bone greater than the 97th centile for age (objective); or, outer edge of the helix more than 2 cm from the mastoid at the point of maximum distance (objective). Evidence: TAS. Frequency: Occasional (HP:0040283). (ORPHA:352665)
- Underdeveloped nasal alae (HP:0000430): Thinned, deficient, or excessively arched ala nasi. Evidence: TAS. Frequency: Occasional (HP:0040283). (ORPHA:352665)
- Cystic hygroma (HP:0000476): A cystic lymphatic lesion of the neck. Evidence: TAS. Frequency: Occasional (HP:0040283). (ORPHA:352665)
- Ptosis (HP:0000508): The upper eyelid margin is positioned 3 mm or more lower than usual and covers the superior portion of the iris (objective); or, the upper lid margin obscures at least part of the pupil (subjective). Evidence: TAS. Frequency: Occasional (HP:0040283). (ORPHA:352665)
- Hypermetropia (HP:0000540): An abnormality of refraction characterized by the ability to see objects in the distance clearly, while objects nearby appear blurry. Evidence: TAS. Frequency: Occasional (HP:0040283). (ORPHA:352665)
- Myopia (HP:0000545): An abnormality of refraction characterized by the ability to see objects nearby clearly, while objects in the distance appear blurry. Evidence: TAS. Frequency: Occasional (HP:0040283). (ORPHA:352665)
- Shallow orbits (HP:0000586): Reduced depth of the orbits associated with prominent-appearing ocular globes. Evidence: TAS. Frequency: Occasional (HP:0040283). (ORPHA:352665)
- Abnormal optic nerve morphology (HP:0000587): Abnormality of the optic nerve. Evidence: TAS. Frequency: Occasional (HP:0040283). (ORPHA:352665)
- Coloboma (HP:0000589): A developmental defect characterized by a cleft of some portion of the eye or ocular adnexa. Evidence: TAS. Frequency: Occasional (HP:0040283). (ORPHA:352665)
- Optic nerve hypoplasia (HP:0000609): Underdevelopment of the optic nerve. Evidence: TAS. Frequency: Occasional (HP:0040283). (ORPHA:352665)
- Hypothyroidism (HP:0000821): Deficiency of thyroid hormone. Evidence: TAS. Frequency: Occasional (HP:0040283). (ORPHA:352665)
- Osteopenia (HP:0000938): Osteopenia is a term to define bone density that is not normal but also not as low as osteoporosis. By definition from the World Health Organization osteopenia is defined by bone densitometry as a T score -1 to -2.5. Evidence: TAS. Frequency: Occasional (HP:0040283). (ORPHA:352665)
- Hyperhidrosis (HP:0000975): Abnormal excessive perspiration (sweating) despite the lack of appropriate stimuli like hot and humid weather. Evidence: TAS. Frequency: Occasional (HP:0040283). (ORPHA:352665)
- Seizure (HP:0001250): A seizure is an intermittent abnormality of nervous system physiology characterized by a transient occurrence of signs and/or symptoms due to abnormal excessive or synchronous neuronal activity in the brain. Evidence: TAS. Frequency: Occasional (HP:0040283). (ORPHA:352665)
- Agenesis of corpus callosum (HP:0001274): Absence of the corpus callosum as a result of the failure of the corpus callosum to develop, which can be the result of a failure in any one of the multiple steps of callosal development including cellular proliferation and migration, axonal growth or glial patterning at the midline. Evidence: TAS. Frequency: Occasional (HP:0040283). (ORPHA:352665)
- Areflexia (HP:0001284): Absence of neurologic reflexes such as the knee-jerk reaction. Evidence: TAS. Frequency: Occasional (HP:0040283). (ORPHA:352665)
- Diminished deep tendon reflex (HP:0001315): A reduction (hyporeflexia) or complete absence (areflexia) of the involuntary muscle contraction normally elicited by a reflex stimulus, such as tapping a deep tendon. Evidence: TAS. Frequency: Occasional (HP:0040283). (ORPHA:352665)
- Muscle weakness (HP:0001324): Reduced strength of muscles. Evidence: TAS. Frequency: Occasional (HP:0040283). (ORPHA:352665)
- Joint hypermobility (HP:0001382): The capability that a joint (or a group of joints) has to move, passively and/or actively, beyond normal limits along physiological axes. Evidence: TAS. Frequency: Occasional (HP:0040283). (ORPHA:352665)
- Overgrowth (HP:0001548): Excessive postnatal growth which may comprise increased weight, increased length, and/or increased head circumference. Evidence: TAS. Frequency: Occasional (HP:0040283). (ORPHA:352665)
- Atrial septal defect (HP:0001631): Atrial septal defect (ASD) is a congenital abnormality of the interatrial septum that enables blood flow between the left and right atria via the interatrial septum. Evidence: TAS. Frequency: Occasional (HP:0040283). (ORPHA:352665)
- Bicuspid aortic valve (HP:0001647): The presence of an aortic valve with two instead of the normal three cusps (flaps). Bicuspid aortic valvue is a malformation of a commissure (small space between the attachment of each cusp to the aortic wall) and the adjacent parts of the two corresponding cusps forming a raphe (the fused area of the two underdeveloped cusps turning into a malformed commissure between both cusps; the raphe is a fibrous ridge that extends from the commissure to the free edge of the two underdeveloped, conjoint cusps). Evidence: TAS. Frequency: Occasional (HP:0040283). (ORPHA:352665)
- Talipes equinovarus (HP:0001762): Talipes equinovarus (also called clubfoot) typically has four main components: inversion and adduction of the forefoot; inversion of the heel and hindfoot; equinus (limitation of extension) of the ankle and subtalar joint; and internal rotation of the leg. Evidence: TAS. Frequency: Occasional (HP:0040283). (ORPHA:352665)
- Pes planus (HP:0001763): A foot where the longitudinal arch of the foot is in contact with the ground or floor when the individual is standing; or, in a patient lying supine, a foot where the arch is in contact with the surface of a flat board pressed against the sole of the foot by the examiner with a pressure similar to that expected from weight bearing; or, the height of the arch is reduced. Evidence: TAS. Frequency: Occasional (HP:0040283). (ORPHA:352665)
- Recurrent fever (HP:0001954): Periodic (episodic or recurrent) bouts of fever. Evidence: TAS. Frequency: Occasional (HP:0040283). (ORPHA:352665)
- Constipation (HP:0002019): Infrequent or difficult evacuation of feces. Evidence: TAS. Frequency: Occasional (HP:0040283). (ORPHA:352665)
- Heat intolerance (HP:0002046): The inability to maintain a comfortable body temperature in warm or hot weather. Evidence: TAS. Frequency: Occasional (HP:0040283). (ORPHA:352665)
- Hypoplasia of the corpus callosum (HP:0002079): Underdevelopment of the corpus callosum. Evidence: TAS. Frequency: Occasional (HP:0040283). (ORPHA:352665)
- Exaggerated cupid's bow (HP:0002263): More pronounced paramedian peaks and median notch of the Cupid's bow. Evidence: TAS. Frequency: Occasional (HP:0040283). (ORPHA:352665)
- Supernumerary nipple (HP:0002558): Presence of more than two nipples. Evidence: TAS. Frequency: Occasional (HP:0040283). (ORPHA:352665)
- Episodic vomiting (HP:0002572): Paroxysmal, recurrent episodes of vomiting. Evidence: TAS. Frequency: Occasional (HP:0040283). (ORPHA:352665)
- Gastroparesis (HP:0002578): Decreased strength of the muscle layer of stomach, which leads to a decreased ability to empty the contents of the stomach despite the absence of obstruction. Evidence: TAS. Frequency: Occasional (HP:0040283). (ORPHA:352665)
- Gastrointestinal dysmotility (HP:0002579): Abnormal intestinal contractions, such as spasms and intestinal paralysis, related to the loss of the ability of the gut to coordinate muscular activity because of endogenous or exogenous causes. Evidence: TAS. Frequency: Occasional (HP:0040283). (ORPHA:352665)
- High, narrow palate (HP:0002705): The presence of a high and narrow palate. Evidence: TAS. Frequency: Occasional (HP:0040283). (ORPHA:352665)
- Nocturnal hypoventilation (HP:0002877): An abnormal reduction in alveolar ventilation occurring during sleep. This is characterized by a rise in arterial carbon dioxide. Evidence: TAS. Frequency: Occasional (HP:0040283). (ORPHA:352665)
- Inverted nipples (HP:0003186): The presence of nipples that instead of pointing outward are retracted inwards. Evidence: TAS. Frequency: Occasional (HP:0040283). (ORPHA:352665)
- Easy fatigability (HP:0003388): Increased susceptibility to fatigue. Evidence: TAS. Frequency: Occasional (HP:0040283). (ORPHA:352665)
- Vertebral segmentation defect (HP:0003422): An abnormality related to a defect of vertebral separation during development. Evidence: TAS. Frequency: Occasional (HP:0040283). (ORPHA:352665)
- Intestinal pseudo-obstruction (HP:0004389): A functional rather than mechanical obstruction of the intestines, associated with manifestations that resemble those caused by an intestinal obstruction, including distension, abdominal pain, nausea, vomiting, constipation or diarrhea, in an individual in whom a mechanical blockage has been excluded. Evidence: TAS. Frequency: Occasional (HP:0040283). (ORPHA:352665)
- Sagittal craniosynostosis (HP:0004442): A kind of craniosynostosis affecting the sagittal suture. Evidence: TAS. Frequency: Occasional (HP:0040283). (ORPHA:352665)
- Lambdoidal craniosynostosis (HP:0004443): A kind of craniosynostosis affecting the lambdoidal suture. Evidence: TAS. Frequency: Occasional (HP:0040283). (ORPHA:352665)
- Preauricular pit (HP:0004467): Small indentation anterior to the insertion of the ear. Evidence: TAS. Frequency: Occasional (HP:0040283). (ORPHA:352665)
- Aortic aneurysm (HP:0004942): Aortic dilatation refers to a dimension that is greater than the 95th percentile for the normal person age, sex and body size. In contrast, an aneurysm is defined as a localized dilation of the aorta that is more than 150 percent of predicted (ratio of observed to expected diameter 1.5 or more). Aneurysm should be distinguished from ectasia, which represents a diffuse dilation of the aorta less than 50 percent of normal aorta diameter. Evidence: TAS. Frequency: Occasional (HP:0040283). (ORPHA:352665)
- Prominent metopic ridge (HP:0005487): Vertical bony ridge positioned in the midline of the forehead. Evidence: TAS. Frequency: Occasional (HP:0040283). (ORPHA:352665)
- Abnormal primary tooth morphology (HP:0006481): Any abnormality of the primary tooth. Evidence: TAS. Frequency: Occasional (HP:0040283). (ORPHA:352665)
- Impaired pain sensation (HP:0007328): Reduced ability to perceive painful stimuli. Evidence: TAS. Frequency: Occasional (HP:0040283). (ORPHA:352665)
- Eversion of lateral third of lower eyelids (HP:0007655). Evidence: TAS. Frequency: Occasional (HP:0040283). (ORPHA:352665)
- Feeding difficulties in infancy (HP:0008872): Impaired feeding performance of an infant as manifested by difficulties such as weak and ineffective sucking, brief bursts of sucking, and falling asleep during sucking. There may be difficulties with chewing or maintaining attention. Evidence: TAS. Frequency: Occasional (HP:0040283). (ORPHA:352665)
- Branchial anomaly (HP:0009794): Congenital developmental defect arising from the primitive branchial apparatus. Evidence: TAS. Frequency: Occasional (HP:0040283). (ORPHA:352665)
- Tooth agenesis (HP:0009804): The absence of one or more teeth from the normal series by a failure to develop. Evidence: TAS. Frequency: Occasional (HP:0040283). (ORPHA:352665)
- Bifid tongue (HP:0010297): Tongue with a median apical indentation or fork. Evidence: TAS. Frequency: Occasional (HP:0040283). (ORPHA:352665)
- Open bite (HP:0010807): Visible space between the dental arches in occlusion. Evidence: TAS. Frequency: Occasional (HP:0040283). (ORPHA:352665)
- Typical absence seizure (HP:0011147): A typical absence seizure is a type of generalized non-motor (absence) seizure characterized by its sudden onset, interruption of ongoing activities, a blank stare, possibly a brief upward deviation of the eyes. Usually the patient will be unresponsive when spoken to. Duration is a few seconds to half a minute with very rapid recovery. Although not always available, an EEG would usually show 3 Hz generalized epileptiform discharges during the event. Evidence: TAS. Frequency: Occasional (HP:0040283). (ORPHA:352665)
- Metopic synostosis (HP:0011330): Premature fusion of the metopic suture. Evidence: TAS. Frequency: Occasional (HP:0040283). (ORPHA:352665)
- Nasogastric tube feeding in infancy (HP:0011470): Feeding problem necessitating nasogastric tube feeding. Evidence: TAS. Frequency: Occasional (HP:0040283). (ORPHA:352665)
- Type 1 muscle fiber atrophy (HP:0011807): Atrophy (wasting) affecting primary type 1 muscle fibers. This feature in general can only be observed on muscle biopsy. Evidence: TAS. Frequency: Occasional (HP:0040283). (ORPHA:352665)
- Postaxial polydactyly (HP:0100259): A form of polydactyly in which the extra digit or digits are localized on the side of the fifth finger or fifth toe. Evidence: TAS. Frequency: Occasional (HP:0040283). (ORPHA:352665)
These phenotypes are associated with the disease Neurodevelopmental disorder-craniofacial dysmorphism-cardiac defect-skeletal anomalies syndrome due to 9q21.3 microdeletion (ORPHA:352665).